Phenotypes associated with the disease cataract 31 multiple types (OMIM:605387):
- Nuclear cataract (HP:0100018): A nuclear cataract is an opacity or clouding that develops in the lens nucleus. That is, a nuclear cataract is one that is located in the center of the lens. The nucleus tends to darken changing from clear to yellow and sometimes brown. Evidence: TAS. (OMIM:605387)
- Anterior subcapsular cataract (HP:0010923): A type of cataract affecting the anterior pole of lens immediately adjacent to ('beneath') the lens capsule. Evidence: TAS. (OMIM:605387)
- Posterior subcapsular cataract (HP:0007787): A type of cataract affecting the posterior pole of lens immediately adjacent to ('beneath') the Lens capsule. Evidence: PCS. (PMID:17701905)
- Autosomal dominant inheritance (HP:0000006): A mode of inheritance that is observed for traits related to a gene encoded on one of the autosomes (i.e., the human chromosomes 1-22) in which a trait manifests in heterozygotes. In the context of medical genetics, an autosomal dominant disorder is caused when a single copy of the mutant allele is present. Males and females are affected equally, and can both transmit the disorder with a risk of 50% for each child of inheriting the mutant allele. Evidence: PCS. (PMID:17701905)